- Ventricular fibrillation (HP:0001663): Uncontrolled contractions of muscles fibers in the left ventricle not producing contraction of the left ventricle. Ventricular fibrillation usually begins with a ventricular premature contraction and a short run of rapid ventricular tachycardia degenerating into uncoordinating ventricular fibrillations. Evidence: PCS. (PMID:17967977)
- First degree atrioventricular block (HP:0011705): Delay of conduction through the atrioventricular node, which is manifested as prolongation of the PR interval in the electrocardiogram (EKG). All atrial impulses reach the ventricles. Evidence: PCS. (PMID:17967977)
- Complete right bundle branch block (HP:0011712): A conduction block of the right branch of the bundle of His. This manifests as a prolongation of the QRS complex (greater than 0.12 s) with delayed activation of the right ventricle and terminal delay on the EKG. Evidence: PCS. (PMID:17967977)
- Syncope (HP:0001279): A transient loss of consciousness (i.e., characterized by a rapid onset, a short duration, and a spontaneous and complete recovery) due to cerebral hypoperfusion. Evidence: PCS. (PMID:17967977)
- Autosomal dominant inheritance (HP:0000006): A mode of inheritance that is observed for traits related to a gene encoded on one of the autosomes (i.e., the human chromosomes 1-22) in which a trait manifests in heterozygotes. In the context of medical genetics, an autosomal dominant disorder is caused when a single copy of the mutant allele is present. Males and females are affected equally, and can both transmit the disorder with a risk of 50% for each child of inheriting the mutant allele. Evidence: PCS. (PMID:17967977)
- Sudden cardiac death (HP:0001645): The heart suddenly and unexpectedly stops beating resulting in death within a short time period (generally within 1 h of symptom onset). Evidence: PCS. Frequency: Occasional (HP:0040283). (PMID:17967977)
- Prolonged PR interval (HP:0012248): Increased time for the PR interval (beginning of the P wave to the beginning of the QRS complex). Evidence: PCS. Frequency: 7/12. (PMID:11839626)
These phenotypes are associated with the disease Brugada syndrome 2 (OMIM:611777).